Phenotypes associated with the disease Legionnaires disease (ORPHA:549, an Orphanet rare-disease identifier):
- Renal insufficiency (HP:0000083, a Human Phenotype Ontology term): A reduction in the level of performance of the kidneys in areas of function comprising the concentration of urine, removal of wastes, the maintenance of electrolyte balance, homeostasis of blood pressure, and calcium metabolism. Evidence: TAS. Frequency: Occasional (HP:0040283, a Human Phenotype Ontology term). (ORPHA:549)
- Proteinuria (HP:0000093, a Human Phenotype Ontology term): Increased levels of protein in the urine. Evidence: TAS. Frequency: Occasional (HP:0040283, a Human Phenotype Ontology term). (ORPHA:549)
- Hallucinations (HP:0000738, a Human Phenotype Ontology term): Perceptions in a conscious and awake state that, in the absence of external stimuli, have qualities of real perception. These perceptions are vivid, substantial, and located in external objective space. Evidence: TAS. Frequency: Occasional (HP:0040283, a Human Phenotype Ontology term). (ORPHA:549)
- Hematuria (HP:0000790, a Human Phenotype Ontology term): The presence of blood in the urine. Hematuria may be gross hematuria (visible to the naked eye) or microscopic hematuria (detected by dipstick or microscopic examination of the urine). Evidence: TAS. Frequency: Occasional (HP:0040283, a Human Phenotype Ontology term). (ORPHA:549)
- Jaundice (HP:0000952, a Human Phenotype Ontology term): Yellow pigmentation of the skin due to bilirubin, which in turn is the result of increased bilirubin concentration in the bloodstream. Evidence: TAS. Frequency: Occasional (HP:0040283, a Human Phenotype Ontology term). (ORPHA:549)
- Ataxia (HP:0001251, a Human Phenotype Ontology term): Ataxia refers to impaired coordination of voluntary muscle movement. Cerebellar ataxia refers to ataxia due to dysfunction of the cerebellum. This causes a variety of elementary neurological deficits including asynergy (lack of coordination between muscles, limbs and joints), dysmetria (lack of ability to judge distances that can lead to under- or overshoot in grasping movements), and dysdiadochokinesia (inability to perform rapid movements requiring antagonizing muscle groups to be switched on and off repeatedly). Evidence: TAS. Frequency: Occasional (HP:0040283, a Human Phenotype Ontology term). (ORPHA:549)
- Muscle weakness (HP:0001324, a Human Phenotype Ontology term): Reduced strength of muscles. Evidence: TAS. Frequency: Occasional (HP:0040283, a Human Phenotype Ontology term). (ORPHA:549)
- Pericarditis (HP:0001701, a Human Phenotype Ontology term): Inflammation of the sac-like covering around the heart (pericardium). Evidence: TAS. Frequency: Occasional (HP:0040283, a Human Phenotype Ontology term). (ORPHA:549)
- Pancreatitis (HP:0001733, a Human Phenotype Ontology term): The presence of inflammation in the pancreas. Evidence: TAS. Frequency: Occasional (HP:0040283, a Human Phenotype Ontology term). (ORPHA:549)
- Splenomegaly (HP:0001744, a Human Phenotype Ontology term): Abnormal increased size of the spleen. Evidence: TAS. Frequency: Occasional (HP:0040283, a Human Phenotype Ontology term). (ORPHA:549)
- Decreased total lymphocyte count (HP:0001888, a Human Phenotype Ontology term): A reduced number of lymphocytes in the blood. Evidence: TAS. Frequency: Occasional (HP:0040283, a Human Phenotype Ontology term). (ORPHA:549)
- Fever (HP:0001945, a Human Phenotype Ontology term): Body temperature elevated above the normal range. Evidence: TAS. Frequency: Very frequent (HP:0040281, a Human Phenotype Ontology term). (ORPHA:549)
- Diarrhea (HP:0002014, a Human Phenotype Ontology term): Abnormally increased frequency (usually defined as three or more) loose or watery bowel movements a day. Evidence: TAS. Frequency: Occasional (HP:0040283, a Human Phenotype Ontology term). (ORPHA:549)
- Nausea and vomiting (HP:0002017, a Human Phenotype Ontology term): Nausea is a commonly encountered symptom that has been defined as an unpleasant painless subjective feeling that one will imminently vomit. Vomiting has been defined as the forceful expulsion of the contents of the stomach, duodenum, or jejunum through the oral cavity. While nausea and vomiting are often thought to exist on a temporal continuum, this is not always the case. There are situations when severe nausea may be present without emesis and less frequently, when emesis may be present without preceding nausea. Evidence: TAS. Frequency: Occasional (HP:0040283, a Human Phenotype Ontology term). (ORPHA:549)
- Abdominal pain (HP:0002027, a Human Phenotype Ontology term): An unpleasant sensation characterized by physical discomfort (such as pricking, throbbing, or aching) and perceived to originate in the abdomen. Evidence: TAS. Frequency: Occasional (HP:0040283, a Human Phenotype Ontology term). (ORPHA:549)
- Anorexia (HP:0002039, a Human Phenotype Ontology term): Lack of desire to eat (loss of appetite). Evidence: TAS. Frequency: Occasional (HP:0040283, a Human Phenotype Ontology term). (ORPHA:549)
- Migraine (HP:0002076, a Human Phenotype Ontology term): Migraine is a chronic neurological disorder characterized by episodic attacks of headache and associated symptoms. Evidence: TAS. Frequency: Occasional (HP:0040283, a Human Phenotype Ontology term). (ORPHA:549)
- Abnormal lung morphology (HP:0002088, a Human Phenotype Ontology term): Any structural anomaly of the lung. Evidence: TAS. Frequency: Very frequent (HP:0040281, a Human Phenotype Ontology term). (ORPHA:549)
- Restrictive ventilatory defect (HP:0002091, a Human Phenotype Ontology term): A functional defect characterized by reduced total lung capacity (TLC) not associated with abnormalities of expiratory airflow or airway resistance. Spirometrically, a restrictive defect is defined as FEV1 (forced expiratory volume in 1 second) and FVC (forced vital capacity) less than 80 per cent. Restrictive lung disease may be caused by alterations in lung parenchyma or because of a disease of the pleura, chest wall, or neuromuscular apparatus. Evidence: TAS. Frequency: Occasional (HP:0040283, a Human Phenotype Ontology term). (ORPHA:549)
- Respiratory insufficiency (HP:0002093, a Human Phenotype Ontology term). Evidence: TAS. Frequency: Frequent (HP:0040282, a Human Phenotype Ontology term). (ORPHA:549)
- Abnormal pleura morphology (HP:0002103, a Human Phenotype Ontology term): An abnormality of the pulmonary pleura, the thin, transparent membrane which covers the lungs and lines the inside of the chest walls. Evidence: TAS. Frequency: Occasional (HP:0040283, a Human Phenotype Ontology term). (ORPHA:549)
- Hemoptysis (HP:0002105, a Human Phenotype Ontology term): Coughing up (expectoration) of blood or blood-streaked sputum from the larynx, trachea, bronchi, or lungs. Evidence: TAS. Frequency: Occasional (HP:0040283, a Human Phenotype Ontology term). (ORPHA:549)
- Pulmonary infiltrates (HP:0002113, a Human Phenotype Ontology term). Evidence: TAS. Frequency: Very frequent (HP:0040281, a Human Phenotype Ontology term). (ORPHA:549)
- Infectious encephalitis (HP:0002383, a Human Phenotype Ontology term): A disorder of the brain caused by an infectious agent that presents with fever, headache, and an altered level of consciousness. There may also be focal or multifocal neurologic deficits, and focal or generalized seizure activity. Evidence: TAS. Frequency: Occasional (HP:0040283, a Human Phenotype Ontology term). (ORPHA:549)
- Hypotension (HP:0002615, a Human Phenotype Ontology term): Low Blood Pressure, vascular hypotension. Evidence: TAS. Frequency: Occasional (HP:0040283, a Human Phenotype Ontology term). (ORPHA:549)
- Lymphadenopathy (HP:0002716, a Human Phenotype Ontology term): Enlargement (swelling) of a lymph node. Evidence: TAS. Frequency: Occasional (HP:0040283, a Human Phenotype Ontology term). (ORPHA:549)
- Arthralgia (HP:0002829, a Human Phenotype Ontology term): Joint pain. Evidence: TAS. Frequency: Occasional (HP:0040283, a Human Phenotype Ontology term). (ORPHA:549)
- Hyponatremia (HP:0002902, a Human Phenotype Ontology term): The concentration of sodium in the blood circulation is below the lower limit of normal. Evidence: TAS. Frequency: Occasional (HP:0040283, a Human Phenotype Ontology term). (ORPHA:549)
- Myalgia (HP:0003326, a Human Phenotype Ontology term): Pain in muscle. Evidence: TAS. Frequency: Very frequent (HP:0040281, a Human Phenotype Ontology term). (ORPHA:549)
- Reduced consciousness (HP:0004372, a Human Phenotype Ontology term): Abnormally diminished level of attention, responsiveness, or wakefulness. Evidence: TAS. Frequency: Occasional (HP:0040283, a Human Phenotype Ontology term). (ORPHA:549)
- Bone marrow hypocellularity (HP:0005528, a Human Phenotype Ontology term): A reduced number of hematopoietic cells present in the bone marrow relative to marrow fat. Evidence: TAS. Frequency: Occasional (HP:0040283, a Human Phenotype Ontology term). (ORPHA:549)
- Peripheral neuropathy (HP:0009830, a Human Phenotype Ontology term): Peripheral neuropathy is a general term for any disorder of the peripheral nervous system. The main clinical features used to classify peripheral neuropathy are distribution, type (mainly demyelinating versus mainly axonal), duration, and course. Evidence: TAS. Frequency: Occasional (HP:0040283, a Human Phenotype Ontology term). (ORPHA:549)
- Arrhythmia (HP:0011675, a Human Phenotype Ontology term): Any cardiac rhythm other than the normal sinus rhythm. Such a rhythm may be either of sinus or ectopic origin and either regular or irregular. An arrhythmia may be due to a disturbance in impulse formation or conduction or both. Evidence: TAS. Frequency: Frequent (HP:0040282, a Human Phenotype Ontology term). (ORPHA:549)
- Hepatitis (HP:0012115, a Human Phenotype Ontology term): Inflammation of the liver. Evidence: TAS. Frequency: Occasional (HP:0040283, a Human Phenotype Ontology term). (ORPHA:549)
- Fatigue (HP:0012378, a Human Phenotype Ontology term): A subjective feeling of tiredness characterized by a lack of energy and motivation. Evidence: TAS. Frequency: Very frequent (HP:0040281, a Human Phenotype Ontology term). (ORPHA:549)
- Cough (HP:0012735, a Human Phenotype Ontology term): A sudden, audible expulsion of air from the lungs through a partially closed glottis, preceded by inhalation. Evidence: TAS. Frequency: Very frequent (HP:0040281, a Human Phenotype Ontology term). (ORPHA:549)
- Myocarditis (HP:0012819, a Human Phenotype Ontology term): Inflammation of the myocardium. Evidence: TAS. Frequency: Occasional (HP:0040283, a Human Phenotype Ontology term). (ORPHA:549)
- Endocarditis (HP:0100584, a Human Phenotype Ontology term): An inflammation of the endocardium, the inner layer of the heart, which usually involves the heart valves. Evidence: TAS. Frequency: Occasional (HP:0040283, a Human Phenotype Ontology term). (ORPHA:549)
- Cellulitis (HP:0100658, a Human Phenotype Ontology term): A bacterial infection and inflammation of the skin und subcutaneous tissues. Evidence: TAS. Frequency: Occasional (HP:0040283, a Human Phenotype Ontology term). (ORPHA:549)
- Chest pain (HP:0100749, a Human Phenotype Ontology term): An unpleasant sensation characterized by physical discomfort (such as pricking, throbbing, or aching) localized to the chest. Evidence: TAS. Frequency: Frequent (HP:0040282, a Human Phenotype Ontology term). (ORPHA:549)
- Recurrent pharyngitis (HP:0100776, a Human Phenotype Ontology term): Increased susceptibility to pharyngitis, as manifested by recurrent episodes of pharyngeal infection that are unusual in frequency or severity for a healthy individual of the same age. Evidence: TAS. Frequency: Occasional (HP:0040283, a Human Phenotype Ontology term). (ORPHA:549)
- Sepsis (HP:0100806, a Human Phenotype Ontology term): Sepsis is defined as life-threatening organ dysfunction caused by a dysregulated host response to infection. Evidence: TAS. Frequency: Occasional (HP:0040283, a Human Phenotype Ontology term). (ORPHA:549)